- Metabolic acidosis (HP:0001942): Metabolic acidosis (MA) is characterized by a fall in blood pH due to a reduction of serum bicarbonate concentration. This can occur as a result of either the accumulation of acids (high anion gap MA) or the loss of bicarbonate from the gastrointestinal tract or the kidney (hyperchloremic MA). By definition, MA is not due to a respirary cause. Evidence: TAS. Frequency: Very frequent (HP:0040281). (ORPHA:31825)
- Visual impairment (HP:0000505): Visual impairment (or vision impairment) is vision loss (of a person) to such a degree as to qualify as an additional support need through a significant limitation of visual capability resulting from either disease, trauma, or congenital or degenerative conditions that cannot be corrected by conventional means, such as refractive correction, medication, or surgery. Evidence: TAS. Frequency: Frequent (HP:0040282). (ORPHA:31825)
- Blurred vision (HP:0000622): Lack of sharpness of vision resulting in the inability to see fine detail. Evidence: TAS. Frequency: Frequent (HP:0040282). (ORPHA:31825)
- Hypertension (HP:0000822): The presence of chronic increased pressure in the systemic arterial system. Evidence: TAS. Frequency: Frequent (HP:0040282). (ORPHA:31825)
- Intracranial hemorrhage (HP:0002170): Hemorrhage occurring within the skull. Evidence: TAS. Frequency: Frequent (HP:0040282). (ORPHA:31825)
- Hyperlipidemia (HP:0003077): An elevated lipid concentration in the blood. Evidence: TAS. Frequency: Frequent (HP:0040282). (ORPHA:31825)
- Addictive alcohol use (HP:0030955): An addictive behavior is defined as drinking excessive amounts of alcohol over a prolonged period of time, having difficulty in reducing the amount of alcohol consumed, strongly desiring alcohol, and experiencing withdrawal symptoms when not drinking alcohol. Evidence: TAS. Frequency: Frequent (HP:0040282). (ORPHA:31825)
- Abnormal putamen morphology (HP:0031982): Any structural anomaly of the putamen, a brain nucleus which together with the caudate nucleus and fundus striati makes up the striatum. Evidence: TAS. Frequency: Frequent (HP:0040282). (ORPHA:31825)
- Abnormal optic nerve morphology (HP:0000587): Abnormality of the optic nerve. Evidence: TAS. Frequency: Occasional (HP:0040283). (ORPHA:31825)
- Blindness (HP:0000618): Blindness is the condition of lacking visual perception defined as a profound reduction in visual perception. On the 6m visual acuity scale, blindness is defined as less than 3/60. On the 20ft visual acuity scale, blindness is defined as less than 20/400. On the decimal visual acuity scale, blindness is defined as less than 0.05. Blindness is typically characterized by a visual field of no greater than 10 degrees in radius around central fixation. Evidence: TAS. Frequency: Occasional (HP:0040283). (ORPHA:31825)
- Coma (HP:0001259): The complete absence of wakefulness and consciousness, which is evident through a lack of response to any form of external stimuli. Evidence: TAS. Frequency: Occasional (HP:0040283). (ORPHA:31825)
- Abnormal corpus callosum morphology (HP:0001273): Abnormality of the corpus callosum. Evidence: TAS. Frequency: Occasional (HP:0040283). (ORPHA:31825)
- Confusion (HP:0001289): Lack of clarity and coherence of thought, perception, understanding, or action. Evidence: TAS. Frequency: Occasional (HP:0040283). (ORPHA:31825)
- Myocardial infarction (HP:0001658): Necrosis of the myocardium caused by an obstruction of the blood supply to the heart and often associated with chest pain, shortness of breath, palpitations, and anxiety as well as characteristic EKG findings and elevation of serum markers including creatine kinase-MB fraction and troponin. Evidence: TAS. Frequency: Occasional (HP:0040283). (ORPHA:31825)
- Vomiting (HP:0002013): Forceful ejection of the contents of the stomach through the mouth by means of a series of involuntary spasmic contractions. Evidence: TAS. Frequency: Occasional (HP:0040283). (ORPHA:31825)
- Diarrhea (HP:0002014): Abnormally increased frequency (usually defined as three or more) loose or watery bowel movements a day. Evidence: TAS. Frequency: Occasional (HP:0040283). (ORPHA:31825)
- Abdominal pain (HP:0002027): An unpleasant sensation characterized by physical discomfort (such as pricking, throbbing, or aching) and perceived to originate in the abdomen. Evidence: TAS. Frequency: Occasional (HP:0040283). (ORPHA:31825)
- Abnormal globus pallidus morphology (HP:0002453): An abnormality of the globus pallidus. Evidence: TAS. Frequency: Occasional (HP:0040283). (ORPHA:31825)
- Abnormal cerebral white matter morphology (HP:0002500): An abnormality of the cerebral white matter. Evidence: TAS. Frequency: Occasional (HP:0040283). (ORPHA:31825)
- Type II diabetes mellitus (HP:0005978): A type of diabetes mellitus initially characterized by insulin resistance and hyperinsulinemia and subsequently by glucose interolerance and hyperglycemia. Evidence: TAS. Frequency: Occasional (HP:0040283). (ORPHA:31825)
- Bilateral basal ganglia lesions (HP:0007146). Evidence: TAS. Frequency: Occasional (HP:0040283). (ORPHA:31825)
- Basal ganglia necrosis (HP:0012128): Death of cells in the basal ganglia. This finding can be confirmed by autopsy. It can be suspected with hyperintensities within the basal ganglia on FLAIR and T2-sequences on magnetic resonance imaging. Evidence: TAS. Frequency: Occasional (HP:0040283). (ORPHA:31825)
- Seizure (HP:0001250): A seizure is an intermittent abnormality of nervous system physiology characterized by a transient occurrence of signs and/or symptoms due to abnormal excessive or synchronous neuronal activity in the brain. Evidence: TAS. Frequency: Very rare (HP:0040284). (ORPHA:31825)
- Cerebral hemorrhage (HP:0001342): Hemorrhage into the parenchyma of the brain. Evidence: TAS. Frequency: Very rare (HP:0040284). (ORPHA:31825)
- Abnormal caudate nucleus morphology (HP:0002339): Any structural abnormality of the caudate nucleus. Evidence: TAS. Frequency: Very rare (HP:0040284). (ORPHA:31825)
- Permanent atrial fibrillation (HP:0004754): Atrial fibrillation (AF) that cannot be successfully terminated by cardioversion, and longstanding (more than 1 year) AF, where cardioversion is not indicated or has not been attempted, is termed permanent. Evidence: TAS. Frequency: Very rare (HP:0040284). (ORPHA:31825)
- Inflammatory arteriopathy (HP:0005291). Evidence: TAS. Frequency: Very rare (HP:0040284). (ORPHA:31825)
- Abnormal cerebellar cortex morphology (HP:0031422): Any structural anomaly of the cortex of the cerebellum. Evidence: TAS. Frequency: Very rare (HP:0040284). (ORPHA:31825)
- Type I diabetes mellitus (HP:0100651): A chronic condition in which the pancreas produces little or no insulin. Type I diabetes mellitus is manifested by the sudden onset of severe hyperglycemia with rapid progression to diabetic ketoacidosis unless treated with insulin. Evidence: TAS. Frequency: Very rare (HP:0040284). (ORPHA:31825)
These phenotypes are associated with the disease Methanol poisoning (ORPHA:31825).